- Stroke (HP:0001297): Sudden impairment of blood flow to a part of the brain due to occlusion or rupture of an artery to the brain. Evidence: PCS. Frequency: 3/27. (PMID:24827035)
- Hypertriglyceridemia (HP:0002155): An abnormal increase in the level of triglycerides in the blood. Evidence: PCS. Frequency: 5/27. (PMID:24827035)
- Middle age onset (HP:0003596): A type of adult onset with onset of symptoms at the age of 40 to 60 years. Evidence: PCS. Frequency: 22/27. (PMID:24827035)
- Hypercholesterolemia (HP:0003124): An increased concentration of cholesterol in the blood. Evidence: PCS. Frequency: 11/27. (PMID:24827035)
- Coronary artery stenosis (HP:0005145): Abnormal narrowing of the coronary artery. Evidence: PCS. (PMID:24827035)
- Elevated circulating LDL-C concentration (HP:0003141): The concentration of low-density lipoprotein cholesterol in the blood circulation is above the upper limit of normal. Evidence: PCS. Frequency: 10/27. (PMID:24827035)
- Hyperglycemia (HP:0003074): An increased concentration of glucose in the blood. Evidence: PCS. Frequency: 5/27. (PMID:24827035)
- Abdominal obesity (HP:0012743): Excessive fat around the stomach and abdomen. Evidence: PCS. Frequency: 26/26. (PMID:24827035)
- Young adult onset (HP:0011462): Onset of disease at the age of between 16 and 40 years. Evidence: PCS. Frequency: 5/27. (PMID:24827035)
- Hypertension (HP:0000822): The presence of chronic increased pressure in the systemic arterial system. Evidence: PCS. Frequency: 27/27. (PMID:24827035)
- Myocardial infarction (HP:0001658): Necrosis of the myocardium caused by an obstruction of the blood supply to the heart and often associated with chest pain, shortness of breath, palpitations, and anxiety as well as characteristic EKG findings and elevation of serum markers including creatine kinase-MB fraction and troponin. Evidence: PCS. Frequency: 23/27. (PMID:24827035)
- Truncal obesity (HP:0001956): Obesity located preferentially in the trunk of the body as opposed to the extremities. Evidence: PCS. (PMID:24827035)
- Type II diabetes mellitus (HP:0005978): A type of diabetes mellitus initially characterized by insulin resistance and hyperinsulinemia and subsequently by glucose interolerance and hyperglycemia. Evidence: PCS. Frequency: 25/27. (PMID:24827035)
- Autosomal dominant inheritance (HP:0000006): A mode of inheritance that is observed for traits related to a gene encoded on one of the autosomes (i.e., the human chromosomes 1-22) in which a trait manifests in heterozygotes. In the context of medical genetics, an autosomal dominant disorder is caused when a single copy of the mutant allele is present. Males and females are affected equally, and can both transmit the disorder with a risk of 50% for each child of inheriting the mutant allele. Evidence: PCS. (PMID:24827035)
These phenotypes are associated with the disease abdominal obesity-metabolic syndrome 3 (OMIM:615812).